Phenotypes associated with the disease hydatidiform mole, recurrent, 3 (OMIM:618431):
- Hydatidiform mole (HP:0032192): Hydatidiform mole (HM) is an aberrant human pregnancy with absence of, or abnormal embryonic development, hydropic degeneration of chorionic villi, and excessive proliferation of the trophoblast. Evidence: PCS. Frequency: 2/2. (PMID:30388401)
- Female infertility (HP:0008222). Evidence: PCS. Frequency: 2/2. (PMID:30388401)
- Young adult onset (HP:0011462): Onset of disease at the age of between 16 and 40 years. Evidence: PCS. Frequency: 2/2. (PMID:30388401)
- Autosomal recessive inheritance (HP:0000007): A mode of inheritance that is observed for traits related to a gene encoded on one of the autosomes (i.e., the human chromosomes 1-22) in which a trait manifests in individuals with two pathogenic alleles, either homozygotes (two copies of the same mutant allele) or compound heterozygotes (whereby each copy of a gene has a distinct mutant allele). Evidence: PCS. (PMID:30388401)